- Autosomal dominant inheritance (HP:0000006): A mode of inheritance that is observed for traits related to a gene encoded on one of the autosomes (i.e., the human chromosomes 1-22) in which a trait manifests in heterozygotes. In the context of medical genetics, an autosomal dominant disorder is caused when a single copy of the mutant allele is present. Males and females are affected equally, and can both transmit the disorder with a risk of 50% for each child of inheriting the mutant allele. Evidence: IEA. (OMIM:114900)
- Intestinal carcinoid (HP:0006723). Evidence: IEA. (OMIM:114900)
These phenotypes are associated with the disease intestinal neuroendocrine tumor G1 (OMIM:114900).